- Failure to thrive in infancy (HP:0001531). Evidence: TAS. Frequency: Very frequent (HP:0040281). (ORPHA:2697)
- Arthrogryposis multiplex congenita (HP:0002804): Multiple congenital contractures in different body areas. Evidence: TAS. Frequency: Very frequent (HP:0040281). (ORPHA:2697)
- Renal tubular dysfunction (HP:0000124): Abnormal function of the renal tubule. The basic functional unit of the kidney, the nephron, consists of a renal corpuscle attached to a renal tubule, with roughly 0.8 to 1.5 nephrons per adult kidney. The functions of the renal tubule include reabsorption of water, electrolytes, glucose, and amino acids and secretion of substances such as uric acid. Evidence: TAS. Frequency: Frequent (HP:0040282). (ORPHA:2697)
- Hyperkeratosis (HP:0000962): Hyperkeratosis is a histopathological term defining a thickened stratum corneum and may be present in many different skin conditions, with many possible overlaps. Hyperkeratosis refers to the increased thickness of the stratum corneum, the outer layer of the skin. Hyperkeratosis is subclassified as orthokeratotic or parakeratotic. Orthokeratotic hyperkeratosis refers to the thickening of the keratin layer with preserved keratinocyte maturation, while parakeratotic hyperkeratosis shows retained nuclei as a sign of delayed maturation of keratinocytes. Evidence: TAS. Frequency: Frequent (HP:0040282). (ORPHA:2697)
- Intellectual disability (HP:0001249): The term intellectual disability or intellectual developmental disorder is used to describe significantly sub-average intellectual and adaptive functioning based on clinical assessment and as measured by individually administered, appropriately normed, standardized and validated tests of intellectual functioning and adaptive behavior, with onset during the developmental period from infancy through adolescence. Evidence: TAS. Frequency: Frequent (HP:0040282). (ORPHA:2697)
- Renal Fanconi syndrome (HP:0001994): An inability of the tubules in the kidney to reabsorb small molecules, causing increased urinary loss of electrolytes (sodium, potassium, bicarbonate), minerals, glucose, amino acids, and water. Evidence: TAS. Frequency: Frequent (HP:0040282). (ORPHA:2697)
- Chronic diarrhea (HP:0002028): The presence of chronic diarrhea, which is usually taken to mean diarrhea that has persisted for over 4 weeks. Evidence: TAS. Frequency: Frequent (HP:0040282). (ORPHA:2697)
- Hepatomegaly (HP:0002240): Abnormally increased size of the liver. Evidence: TAS. Frequency: Frequent (HP:0040282). (ORPHA:2697)
- Recurrent infections (HP:0002719): Increased susceptibility to infections as manifested by repeated bouts of infection. Evidence: TAS. Frequency: Frequent (HP:0040282). (ORPHA:2697)
- Conjugated hyperbilirubinemia (HP:0002908). Evidence: TAS. Frequency: Frequent (HP:0040282). (ORPHA:2697)
- Neonatal cholestatic liver disease (HP:0006566). Evidence: TAS. Frequency: Frequent (HP:0040282). (ORPHA:2697)
- Aplasia/Hypoplasia of the corpus callosum (HP:0007370): Absence or underdevelopment of the corpus callosum. Evidence: TAS. Frequency: Frequent (HP:0040282). (ORPHA:2697)
- Ichthyosis (HP:0008064): An abnormality of the skin characterized the presence of excessive amounts of dry surface scales on the skin resulting from an abnormality of keratinization. Evidence: TAS. Frequency: Frequent (HP:0040282). (ORPHA:2697)
- Congenital bilateral hip dislocation (HP:0008780). Evidence: TAS. Frequency: Frequent (HP:0040282). (ORPHA:2697)
- Abnormal platelet count (HP:0011873): Abnormal number of platelets per volume of blood. In a healthy adult, a normal platelet count is between 150,000 and 450,000 per microliter of blood. Evidence: TAS. Frequency: Frequent (HP:0040282). (ORPHA:2697)
- Abnormal alpha granules (HP:0012483): Defective structure, size or content of alpha granules, platelet organelles that contain several growth factors destined for release during platelet activation at sites of vessel wall injury. Evidence: TAS. Frequency: Frequent (HP:0040282). (ORPHA:2697)
- Abnormal platelet aggregation (HP:0030402): An abnormality in the rate and degree to which platelets aggregate after the addition of an agonist that stimulates platelet clumping. Platelet aggregation is measured using aggregometer to measure the optical density of platelet-rich plasma, whereby platelet aggregation causes the plasma to become more transparent. Evidence: TAS. Frequency: Frequent (HP:0040282). (ORPHA:2697)
- Nephrocalcinosis (HP:0000121): Nephrocalcinosis is the deposition of calcium salts in renal parenchyma. Evidence: TAS. Frequency: Occasional (HP:0040283). (ORPHA:2697)
- Microcephaly (HP:0000252): Head circumference below 2 standard deviations below the mean for age and gender. Evidence: TAS. Frequency: Occasional (HP:0040283). (ORPHA:2697)
- Hearing impairment (HP:0000365): A decreased magnitude of the sensory perception of sound. Evidence: TAS. Frequency: Occasional (HP:0040283). (ORPHA:2697)
- Low-set ears (HP:0000369): Upper insertion of the ear to the scalp below an imaginary horizontal line drawn between the inner canthi of the eye and extending posteriorly to the ear. Evidence: TAS. Frequency: Occasional (HP:0040283). (ORPHA:2697)
- Hypothyroidism (HP:0000821): Deficiency of thyroid hormone. Evidence: TAS. Frequency: Occasional (HP:0040283). (ORPHA:2697)
- Osteopenia (HP:0000938): Osteopenia is a term to define bone density that is not normal but also not as low as osteoporosis. By definition from the World Health Organization osteopenia is defined by bone densitometry as a T score -1 to -2.5. Evidence: TAS. Frequency: Occasional (HP:0040283). (ORPHA:2697)
- Cutis laxa (HP:0000973): Wrinkled, redundant, inelastic and sagging skin. Evidence: TAS. Frequency: Occasional (HP:0040283). (ORPHA:2697)
- Hypotonia (HP:0001252): Hypotonia is an abnormally low muscle tone (the amount of tension or resistance to movement in a muscle). Even when relaxed, muscles have a continuous and passive partial contraction which provides some resistance to passive stretching. Hypotonia thus manifests as diminished resistance to passive stretching. Hypotonia is not the same as muscle weakness, although the two conditions can co-exist. Evidence: TAS. Frequency: Occasional (HP:0040283). (ORPHA:2697)
- Decreased fetal movement (HP:0001558): An abnormal reduction in quantity or strength of fetal movements. Evidence: TAS. Frequency: Occasional (HP:0040283). (ORPHA:2697)
- Oligohydramnios (HP:0001562): Diminished amniotic fluid volume in pregnancy. Evidence: TAS. Frequency: Occasional (HP:0040283). (ORPHA:2697)
- Pathologic fracture (HP:0002756): A pathologic fracture occurs when a bone breaks in an area that is weakened secondarily to another disease process such as tumor, infection, and certain inherited bone disorders. A pathologic fracture can occur without a degree of trauma required to cause fracture in healthy bone. Evidence: TAS. Frequency: Occasional (HP:0040283). (ORPHA:2697)
- Skeletal muscle atrophy (HP:0003202): The presence of skeletal muscular atrophy (which is also known as amyotrophy). Evidence: TAS. Frequency: Occasional (HP:0040283). (ORPHA:2697)
- Intrahepatic biliary atresia (HP:0005248): Atresia in the intrahepatic bile duct. Evidence: TAS. Frequency: Occasional (HP:0040283). (ORPHA:2697)
- Nephrogenic diabetes insipidus (HP:0009806): A form of diabetes insipidus caused by failure of the kidneys to respond to vasopressin (AVP). Evidence: TAS. Frequency: Occasional (HP:0040283). (ORPHA:2697)
These phenotypes are associated with the disease Arthrogryposis-renal dysfunction-cholestasis syndrome (ORPHA:2697).
The following phenotypes are NOT associated with this disease:
- Elevated gamma-glutamyltransferase level (HP:0030948): Increased level of the enzyme gamma-glutamyltransferase (GGT). GGT is mainly present in kidney, liver, and pancreatic cells, but small amounts are present in other tissues. Evidence: TAS. (ORPHA:2697)